Phenotypes associated with the disease Ventilator-induced diaphragmatic dysfunction (ORPHA:505395):
- Abnormality of the diaphragm (HP:0000775): Any abnormality of the diaphragm, the sheet of skeletal muscle that separates the thoracic cavity from the abdominal cavity. Evidence: TAS. Frequency: Very frequent (HP:0040281). (ORPHA:505395)
- Ventilator dependence with inability to wean (HP:0005946). Evidence: TAS. Frequency: Very frequent (HP:0040281). (ORPHA:505395)
- Diaphragmatic weakness (HP:0009113): A decrease in the strength of the diaphragm. Evidence: TAS. Frequency: Very frequent (HP:0040281). (ORPHA:505395)
- Increased reactive oxygen species production (HP:0025464): An accumulation of free radical groups in the body inadequately neutralized by antioxidants, which creates a potentially unstable and damaging cellular environment linked to tissue damage. Evidence: TAS. Frequency: Very frequent (HP:0040281). (ORPHA:505395)
- EMG abnormality (HP:0003457): Abnormal results of investigations using electromyography (EMG). Evidence: TAS. Frequency: Frequent (HP:0040282). (ORPHA:505395)
- Reduced maximal inspiratory pressure (HP:0012496): A decrease in the maximum amount of negative pressure a person can generate during an inhalation. Evidence: TAS. Frequency: Frequent (HP:0040282). (ORPHA:505395)
- Severe infection (HP:0032169): A type of infection that is regarded as a sign of a pathological susceptibility to infection because of unusual severity or intensity of the infection. Evidence: TAS. Frequency: Frequent (HP:0040282). (ORPHA:505395)
- Hypothyroidism (HP:0000821): Deficiency of thyroid hormone. Evidence: TAS. Frequency: Occasional (HP:0040283). (ORPHA:505395)
- Respiratory insufficiency due to muscle weakness (HP:0002747). Evidence: TAS. Frequency: Occasional (HP:0040283). (ORPHA:505395)
- Abdominal symptom (HP:0011458): A subjective manifestation of disease localized to the abdomen. Evidence: TAS. Frequency: Occasional (HP:0040283). (ORPHA:505395)
- Hypercapnia (HP:0012416): Abnormally elevated blood carbon dioxide (CO2) level. Evidence: TAS. Frequency: Occasional (HP:0040283). (ORPHA:505395)
- Reduced forced vital capacity (HP:0032341): An abnormal reduction in the amount of air a person can expel following maximal inspiration. Evidence: TAS. Frequency: Occasional (HP:0040283). (ORPHA:505395)
- Sepsis (HP:0100806): Sepsis is defined as life-threatening organ dysfunction caused by a dysregulated host response to infection. Evidence: TAS. Frequency: Occasional (HP:0040283). (ORPHA:505395)
- Diaphragmatic paralysis (HP:0006597): The presence of a paralyzed diaphragm. Evidence: TAS. Frequency: Very rare (HP:0040284). (ORPHA:505395)